- Woolly hair (HP:0002224): The term wooly hair refers to an abnormal variant of hair that is fine, with tightly coiled curls, and often hypopigmented. Optical microscopy may reveal the presence of tight spirals and a clear diameter reduction as compared with normal hair. Electron microscopy may show flat, oval hair shafts with reduced transversal diameter. Evidence: PCS. Frequency: 0/11. (PMID:12373648)
- Ventricular fibrillation (HP:0001663): Uncontrolled contractions of muscles fibers in the left ventricle not producing contraction of the left ventricle. Ventricular fibrillation usually begins with a ventricular premature contraction and a short run of rapid ventricular tachycardia degenerating into uncoordinating ventricular fibrillations. Evidence: PCS. Frequency: 2/11. (PMID:12373648)
- Early young adult onset (HP:0025708): Onset of disease at an age of greater than or equal to 16 to under 19 years. Evidence: PCS. Frequency: 1/1. (PMID:12373648)
- Premature ventricular contraction (HP:0006682): Premature ventricular contractions (PVC) or ventricular extrasystoles are premature contractions of the heart that arise in response to an impulse in the ventricles rather than the normal impulse from the sinoatrial (SA) node. Evidence: PCS. Frequency: 5/11. (PMID:12373648)
- Congestive heart failure (HP:0001635): The presence of an abnormality of cardiac function that is responsible for the failure of the heart to pump blood at a rate that is commensurate with the needs of the tissues or a state in which abnormally elevated filling pressures are required for the heart to do so. Heart failure is frequently related to a defect in myocardial contraction. Evidence: PCS. Frequency: 1/11. Onset: Late onset (HP:0003584). (PMID:12373648)
- Right ventricular cardiomyopathy (HP:0011663): Right ventricular dysfunction (global or regional) with functional and morphological right ventricular abnormalities, with or without left ventricular disease. Evidence: PCS. Frequency: 11/11. (PMID:12373648)
- Autosomal dominant inheritance (HP:0000006): A mode of inheritance that is observed for traits related to a gene encoded on one of the autosomes (i.e., the human chromosomes 1-22) in which a trait manifests in heterozygotes. In the context of medical genetics, an autosomal dominant disorder is caused when a single copy of the mutant allele is present. Males and females are affected equally, and can both transmit the disorder with a risk of 50% for each child of inheriting the mutant allele. Evidence: PCS. (PMID:12373648)
- Sudden cardiac death (HP:0001645): The heart suddenly and unexpectedly stops beating resulting in death within a short time period (generally within 1 h of symptom onset). Evidence: PCS. Frequency: 2/11. (PMID:12373648)
- Ventricular tachycardia (HP:0004756): A tachycardia originating in the ventricles characterized by rapid heart rate (over 100 beats per minute) and broad QRS complexes (over 120 ms). Evidence: PCS. Frequency: 2/11. (PMID:12373648)
These phenotypes are associated with the disease arrhythmogenic right ventricular dysplasia 8 (OMIM:607450).